- Mandibular prognathia (HP:0000303, a Human Phenotype Ontology term): Abnormal prominence of the chin related to increased length of the mandible. Evidence: TAS. Frequency: Occasional (HP:0040283, a Human Phenotype Ontology term). (ORPHA:1077)
- Abnormal dental enamel morphology (HP:0000682, a Human Phenotype Ontology term): An abnormality of the dental enamel. Evidence: TAS. Frequency: Frequent (HP:0040282, a Human Phenotype Ontology term). (ORPHA:1077)
- Clinodactyly of the 5th finger (HP:0004209, a Human Phenotype Ontology term): Clinodactyly refers to a bending or curvature of the fifth finger in the radial direction (i.e., towards the 4th finger). Evidence: TAS. Frequency: Occasional (HP:0040283, a Human Phenotype Ontology term). (ORPHA:1077)
- Tooth agenesis (HP:0009804, a Human Phenotype Ontology term): The absence of one or more teeth from the normal series by a failure to develop. Evidence: TAS. Frequency: Very frequent (HP:0040281, a Human Phenotype Ontology term). (ORPHA:1077)
These phenotypes are associated with the disease Dental ankylosis (ORPHA:1077, an Orphanet rare-disease identifier).